Phenotypes associated with the disease Pediatric acute respiratory distress syndrome (ORPHA:685082):
- Hypoxemia (HP:0012418): An abnormally low level of blood oxygen. Evidence: TAS. Frequency: Very frequent (HP:0040281). (ORPHA:685082)
- Abnormal thorax morphology (HP:0000765): Any abnormality of the thorax (the region of the body formed by the sternum, the thoracic vertebrae and the ribs). Evidence: TAS. Frequency: Frequent (HP:0040282). (ORPHA:685082)
- Cyanosis (HP:0000961): Bluish discoloration of the skin and mucosa due to poor circulation or inadequate oxygenation of arterial or capillary blood. Evidence: TAS. Frequency: Frequent (HP:0040282). (ORPHA:685082)
- Premature birth (HP:0001622): The birth of a baby of less than 37 weeks of gestational age. Evidence: TAS. Frequency: Frequent (HP:0040282). (ORPHA:685082)
- Tachypnea (HP:0002789): Very rapid breathing. Evidence: TAS. Frequency: Frequent (HP:0040282). (ORPHA:685082)
- Respiratory failure (HP:0002878): A severe form of respiratory insufficiency characterized by inadequate gas exchange such that the levels of oxygen or carbon dioxide cannot be maintained within normal limits. Evidence: TAS. Frequency: Frequent (HP:0040282). (ORPHA:685082)
- Nasal flaring (HP:0030863): Widening of the nostrils upon inhalation as a manifestation of respiratory distress. Evidence: TAS. Frequency: Frequent (HP:0040282). (ORPHA:685082)
- Pulmonary edema (HP:0100598): Fluid accumulation in the lungs. Evidence: TAS. Frequency: Frequent (HP:0040282). (ORPHA:685082)
- Atelectasis (HP:0100750): Collapse of part of a lung associated with absence of inflation (air) of that part. Evidence: TAS. Frequency: Frequent (HP:0040282). (ORPHA:685082)
- Tachycardia (HP:0001649): A rapid heartrate that exceeds the range of the normal resting heartrate for age. Evidence: TAS. Frequency: Occasional (HP:0040283). (ORPHA:685082)
- Bradycardia (HP:0001662): A slower than normal heart rate (in adults, slower than 60 beats per minute). Evidence: TAS. Frequency: Occasional (HP:0040283). (ORPHA:685082)
- Cardiac arrest (HP:0001695): An abrupt loss of heart function. Evidence: TAS. Frequency: Occasional (HP:0040283). (ORPHA:685082)
- Pneumonia (HP:0002090): Inflammation of any part of the lung parenchyma. Evidence: TAS. Frequency: Occasional (HP:0040283). (ORPHA:685082)
- Hypotension (HP:0002615): Low Blood Pressure, vascular hypotension. Evidence: TAS. Frequency: Occasional (HP:0040283). (ORPHA:685082)
- Respiratory tract infection (HP:0011947): An infection of the upper or lower respiratory tract. Evidence: TAS. Frequency: Occasional (HP:0040283). (ORPHA:685082)
- Sepsis (HP:0100806): Sepsis is defined as life-threatening organ dysfunction caused by a dysregulated host response to infection. Evidence: TAS. Frequency: Very rare (HP:0040284). (ORPHA:685082)